Phenotypes associated with the disease thyroid cancer, nonmedullary, 5 (OMIM:616535):
- Non-medullary thyroid carcinoma (HP:0040198). Evidence: TAS. (OMIM:616535)
- Autosomal dominant inheritance (HP:0000006): A mode of inheritance that is observed for traits related to a gene encoded on one of the autosomes (i.e., the human chromosomes 1-22) in which a trait manifests in heterozygotes. In the context of medical genetics, an autosomal dominant disorder is caused when a single copy of the mutant allele is present. Males and females are affected equally, and can both transmit the disorder with a risk of 50% for each child of inheriting the mutant allele. Evidence: TAS. (OMIM:616535)